- Curly hair (HP:0002212). Evidence: IEA. (OMIM:139450)
- Autosomal dominant inheritance (HP:0000006): A mode of inheritance that is observed for traits related to a gene encoded on one of the autosomes (i.e., the human chromosomes 1-22) in which a trait manifests in heterozygotes. In the context of medical genetics, an autosomal dominant disorder is caused when a single copy of the mutant allele is present. Males and females are affected equally, and can both transmit the disorder with a risk of 50% for each child of inheriting the mutant allele. Evidence: IEA. (OMIM:139450)
These phenotypes are associated with the disease HAIR, CURLY (OMIM:139450).